- Abnormal vestibular function (HP:0001751): An abnormality of the functioning of the vestibular apparatus. Evidence: PCS. Frequency: 0/15. (PMID:32776944)
- Sensorineural hearing impairment (HP:0000407): A type of hearing impairment in one or both ears related to an abnormal functionality of the cochlear nerve. Evidence: PCS. Frequency: 15/15. Onset: Adult onset (HP:0003581). (PMID:32776944)
- Adult onset (HP:0003581): Onset of disease manifestations in adulthood, defined here as at the age of 16 years or later. Evidence: PCS. Frequency: 15/15. (PMID:32776944)
- Tinnitus (HP:0000360): Tinnitus is an auditory perception that can be described as the experience of sound, in the ear or in the head, in the absence of external acoustic stimulation. Evidence: PCS. Frequency: 15/15. (PMID:32776944)
- Abnormal inner ear morphology (HP:0011390): A structural anomaly of the internal part of the ear. Evidence: PCS. Frequency: 0/1. (PMID:32776944)
- Autosomal dominant inheritance (HP:0000006): A mode of inheritance that is observed for traits related to a gene encoded on one of the autosomes (i.e., the human chromosomes 1-22) in which a trait manifests in heterozygotes. In the context of medical genetics, an autosomal dominant disorder is caused when a single copy of the mutant allele is present. Males and females are affected equally, and can both transmit the disorder with a risk of 50% for each child of inheriting the mutant allele. Evidence: PCS. (PMID:32776944)
These phenotypes are associated with the disease hearing loss, autosomal dominant 86 (OMIM:620280).